Phenotypes associated with the disease 17q12 microduplication syndrome (ORPHA:261272):
- Cleft palate (HP:0000175): Cleft palate is a developmental defect of the palate resulting from a failure of fusion of the palatine processes and manifesting as a separation of the roof of the mouth (soft and hard palate). Evidence: TAS. Frequency: Occasional (HP:0040283). (ORPHA:261272)
- Deeply set eye (HP:0000490): An eye that is more deeply recessed into the plane of the face than is typical. Evidence: TAS. Frequency: Occasional (HP:0040283). (ORPHA:261272)
- Glaucoma (HP:0000501): Glaucoma refers loss of retinal ganglion cells in a characteristic pattern of optic neuropathy usually associated with increased intraocular pressure. Evidence: TAS. Frequency: Occasional (HP:0040283). (ORPHA:261272)
- Microphthalmia (HP:0000568): A developmental anomaly characterized by abnormal smallness of one or both eyes. Evidence: TAS. Frequency: Occasional (HP:0040283). (ORPHA:261272)
- Synophrys (HP:0000664): Meeting of the medial eyebrows in the midline. Evidence: TAS. Frequency: Occasional (HP:0040283). (ORPHA:261272)
- Delayed speech and language development (HP:0000750): A degree of language development that is significantly below the norm for a child of a specified age. Evidence: TAS. Frequency: Occasional (HP:0040283). (ORPHA:261272)
- Intellectual disability (HP:0001249): The term intellectual disability or intellectual developmental disorder is used to describe significantly sub-average intellectual and adaptive functioning based on clinical assessment and as measured by individually administered, appropriately normed, standardized and validated tests of intellectual functioning and adaptive behavior, with onset during the developmental period from infancy through adolescence. Evidence: TAS. Frequency: Occasional (HP:0040283). (ORPHA:261272)
- Seizure (HP:0001250): A seizure is an intermittent abnormality of nervous system physiology characterized by a transient occurrence of signs and/or symptoms due to abnormal excessive or synchronous neuronal activity in the brain. Evidence: TAS. Frequency: Occasional (HP:0040283). (ORPHA:261272)
- Polyhydramnios (HP:0001561): The presence of excess amniotic fluid in the uterus during pregnancy. Evidence: TAS. Frequency: Occasional (HP:0040283). (ORPHA:261272)
- Atrial septal defect (HP:0001631): Atrial septal defect (ASD) is a congenital abnormality of the interatrial septum that enables blood flow between the left and right atria via the interatrial septum. Evidence: TAS. Frequency: Occasional (HP:0040283). (ORPHA:261272)
- Toe syndactyly (HP:0001770): Webbing or fusion of the toes, involving soft parts only or including bone structure. Bony fusions are referred to as "bony" Syndactyly if the fusion occurs in a radio-ulnar axis. Fusions of bones of the toes in a proximo-distal axis are referred to as "Symphalangism". Evidence: TAS. Frequency: Occasional (HP:0040283). (ORPHA:261272)
- Language impairment (HP:0002463): Language impairment is a deficit in comprehension or production of language that includes reduced vocabulary, limited sentence structure, or impairments in written or spoken communication. Language abilities are substantially and quantifiably below age expectations. Evidence: TAS. Frequency: Occasional (HP:0040283). (ORPHA:261272)
- Cortical dysplasia (HP:0002539): The presence of developmental dysplasia of the cerebral cortex. Evidence: TAS. Frequency: Frequent (HP:0040282). (ORPHA:261272)
- Tracheoesophageal fistula (HP:0002575): An abnormal connection (fistula) between the esophagus and the trachea. Evidence: TAS. Frequency: Occasional (HP:0040283). (ORPHA:261272)
- Abnormal vertebral morphology (HP:0003468): An abnormality of one or more of the vertebrae. Evidence: TAS. Frequency: Occasional (HP:0040283). (ORPHA:261272)
- Finger syndactyly (HP:0006101): Webbing or fusion of the fingers, involving soft parts only or including bone structure. Bony fusions are referred to as "bony" Syndactyly if the fusion occurs in a radio-ulnar axis. Fusions of bones of the fingers in a proximo-distal axis are referred to as "Symphalangism". Evidence: TAS. Frequency: Occasional (HP:0040283). (ORPHA:261272)
- Self-injurious behavior (HP:0100716): Self-aggression. Evidence: TAS. Frequency: Occasional (HP:0040283). (ORPHA:261272)